- Hyperkeratosis lenticularis perstans (HP:0007570): Hyperkeratosis lenticularis perstans (HLP), also known as Flegel disease, is a keratinization abnormality characterized by small, asymptomatic erythematous papules that leave characteristic punctate bleeding when they become detached. The lesions generally occur symmetrically along the top of the foot and on the legs, appearing more rarely on the arms, forearms, palms, and soles, and even on the oral mucosa. Evidence: IEA. (OMIM:144150)
- Adult onset (HP:0003581): Onset of disease manifestations in adulthood, defined here as at the age of 16 years or later. Evidence: IEA. (OMIM:144150)
- Autosomal dominant inheritance (HP:0000006): A mode of inheritance that is observed for traits related to a gene encoded on one of the autosomes (i.e., the human chromosomes 1-22) in which a trait manifests in heterozygotes. In the context of medical genetics, an autosomal dominant disorder is caused when a single copy of the mutant allele is present. Males and females are affected equally, and can both transmit the disorder with a risk of 50% for each child of inheriting the mutant allele. Evidence: IEA. (OMIM:144150)
These phenotypes are associated with the disease hyperkeratosis lenticularis perstans (OMIM:144150).